Phenotypes associated with the disease gastrocutaneous syndrome (OMIM:137270):
- Hiatus hernia (HP:0002036): The presence of a hernia in which the upper part of the stomach, i.e., mainly the gastric cardia protrudes through the diaphragmatic esophageal hiatus. Evidence: IEA. (OMIM:137270)
- Multiple lentigines (HP:0001003): Presence of an unusually high number of lentigines (singular: lentigo), which are flat, tan to brown oval spots. Evidence: IEA. (OMIM:137270)
- Peptic ulcer (HP:0004398): The term peptic ulcer refers to acid peptic injury of the digestive tract, resulting in mucosal break reaching the submucosa. Peptic ulcers are usually located in the stomach or proximal duodenum, but they can also be found in the esophagus or Meckel's diverticulum. Infection with Helicobacter pylori and the use of non steroidal antiinflammatory drugs (NSAIDs) or aspirin are the main risk factors of both gastric and duodenal peptic ulcers. Evidence: IEA. (OMIM:137270)
- Cafe-au-lait spot (HP:0000957): Cafe-au-lait spots are hyperpigmented lesions that can vary in color from light brown to dark brown with smooth borders and having a size of 1.5 cm or more in adults and 0.5 cm or more in children. Evidence: IEA. (OMIM:137270)
- Hypertelorism (HP:0000316): Interpupillary distance more than 2 SD above the mean (alternatively, the appearance of an increased interpupillary distance or widely spaced eyes). Evidence: IEA. (OMIM:137270)
- Autosomal dominant inheritance (HP:0000006): A mode of inheritance that is observed for traits related to a gene encoded on one of the autosomes (i.e., the human chromosomes 1-22) in which a trait manifests in heterozygotes. In the context of medical genetics, an autosomal dominant disorder is caused when a single copy of the mutant allele is present. Males and females are affected equally, and can both transmit the disorder with a risk of 50% for each child of inheriting the mutant allele. Evidence: IEA. (OMIM:137270)
- Myopia (HP:0000545): An abnormality of refraction characterized by the ability to see objects nearby clearly, while objects in the distance appear blurry. Evidence: IEA. (OMIM:137270)